Phenotypes associated with the disease fingerprint body myopathy (OMIM:305550):
- Myopathy (HP:0003198): A disorder of muscle unrelated to impairment of innervation or neuromuscular junction. Evidence: IEA. (OMIM:305550)
- Abnormality of metabolism/homeostasis (HP:0001939). Evidence: IEA. (OMIM:305550)
- X-linked inheritance (HP:0001417): A mode of inheritance that is observed for traits related to a gene encoded on the X chromosome. Evidence: IEA. (OMIM:305550)